- Long philtrum (HP:0000343): Distance between nasal base and midline upper lip vermilion border more than 2 SD above the mean. Alternatively, an apparently increased distance between nasal base and midline upper lip vermilion border. Evidence: PCS. Frequency: 1/7. (PMID:32109419)
- Delayed eruption of teeth (HP:0000684): Delayed tooth eruption, which can be defined as tooth eruption more than 2 SD beyond the mean eruption age. Evidence: PCS. Frequency: 0/8. (PMID:32109419)
- Anteverted nares (HP:0000463): Anteriorly-facing nostrils viewed with the head in the Frankfurt horizontal and the eyes of the observer level with the eyes of the subject. This gives the appearance of an upturned nose (upturned nasal tip). Evidence: PCS. Frequency: 1/7. (PMID:32109419)
- Seizure (HP:0001250): A seizure is an intermittent abnormality of nervous system physiology characterized by a transient occurrence of signs and/or symptoms due to abnormal excessive or synchronous neuronal activity in the brain. Evidence: PCS. Frequency: 3/9. (PMID:32109419)
- Infantile onset (HP:0003593): Onset of signs or symptoms of disease between 28 days to one year of life. Evidence: PCS. Frequency: 9/9. (PMID:32109419)
- Obsessive-compulsive trait (HP:0008770): The presence of one or more obsessive-compulsive personality traits. Obsessions refer to persistent intrusive thoughts, and compulsions to intrusive behaviors, which the affected person experiences as involuntary, senseless, or repugnant. Evidence: PCS. Frequency: 4/8. (PMID:32109419)
- Pain insensitivity (HP:0007021): Inability to perceive painful stimuli. Evidence: PCS. Frequency: 1/8. (PMID:32109419)
- Aggressive behavior (HP:0000718): Behavior or an act aimed at harming a person, animal, or physical property (e.g., acts of physical violence; shouting, swearing, and using harsh language; slashing someone's tires). Evidence: IEA. Frequency: 3/9. (PMID:32109419)
- Chronic constipation (HP:0012450): Constipation for longer than three months with fewer than 3 bowel movements per week, straining, lumpy or hard stools, and a sensation of anorectal obstruction or incomplete defecation. Evidence: PCS. Frequency: 2/9. (PMID:32109419)
- Hypertelorism (HP:0000316): Interpupillary distance more than 2 SD above the mean (alternatively, the appearance of an increased interpupillary distance or widely spaced eyes). Evidence: PCS. Frequency: 1/7. (PMID:32109419)
- Motor stereotypy (HP:0000733): Use of the same abnormal action in response to certain triggers or at random. They may be used as a way to regulate one's internal state but must otherwise have no apparent functional purpose. Evidence: PCS. Frequency: 4/9. (PMID:32109419)
- Feeding difficulties in infancy (HP:0008872): Impaired feeding performance of an infant as manifested by difficulties such as weak and ineffective sucking, brief bursts of sucking, and falling asleep during sucking. There may be difficulties with chewing or maintaining attention. Evidence: PCS. Frequency: 5/8. (PMID:32109419)
- Dental crowding (HP:0000678): Changes in alignment of teeth in the dental arch. Evidence: PCS. Frequency: 1/8. (PMID:32109419)
- Low hanging columella (HP:0009765): Columella extending inferior to the level of the nasal base, when viewed from the side. Evidence: PCS. Frequency: 2/7. (PMID:32109419)
- High palate (HP:0000218): Height of the palate more than 2 SD above the mean (objective) or palatal height at the level of the first permanent molar more than twice the height of the teeth (subjective). Evidence: PCS. Frequency: 1/7. (PMID:32109419)
- Delayed ability to sit (HP:0025336): A failure to achieve the ability to sit at an appropriate developmental stage. Most children sit with support at 6 months of age and sit steadily without support at 9 months of age. Evidence: IEA. Frequency: 2/9. (PMID:32109419)
- Macrocephaly (HP:0000256): Occipitofrontal (head) circumference greater than 97th centile compared to appropriate, age matched, sex-matched normal standards. Alternatively, a apparently increased size of the cranium. Evidence: PCS. Frequency: 7/9. (PMID:32109419)
- Intellectual disability (HP:0001249): The term intellectual disability or intellectual developmental disorder is used to describe significantly sub-average intellectual and adaptive functioning based on clinical assessment and as measured by individually administered, appropriately normed, standardized and validated tests of intellectual functioning and adaptive behavior, with onset during the developmental period from infancy through adolescence. Evidence: PCS. Frequency: 9/9. (PMID:32109419)
- Wide mouth (HP:0000154): Distance between the oral commissures more than 2 SD above the mean. Alternatively, an apparently increased width of the oral aperture (subjective). Evidence: PCS. Frequency: 2/7. (PMID:32109419)
- Highly arched eyebrow (HP:0002553): Increased height of the central portion of the eyebrow, forming a crescent, semicircular, or inverted U shape. Evidence: PCS. Frequency: 2/7. (PMID:32109419)
- Downslanted palpebral fissures (HP:0000494): The palpebral fissure inclination is more than two standard deviations below the mean. Evidence: PCS. Frequency: 1/7. (PMID:32109419)
- Delayed speech and language development (HP:0000750): A degree of language development that is significantly below the norm for a child of a specified age. Evidence: PCS. Frequency: 9/9. (PMID:32109419)
- Scoliosis (HP:0002650): The presence of an abnormal lateral curvature of the spine. Evidence: PCS. Frequency: 4/8. (PMID:32109419)
- Underdeveloped nasal alae (HP:0000430): Thinned, deficient, or excessively arched ala nasi. Evidence: PCS. Frequency: 1/7. (PMID:32109419)
- Short chin (HP:0000331): Decreased vertical distance from the vermilion border of the lower lip to the inferior-most point of the chin. Evidence: PCS. Frequency: 1/7. (PMID:32109419)
- Delayed ability to walk (HP:0031936): A failure to achieve the ability to walk at an appropriate developmental stage. Most children learn to walk in a series of stages, and learn to walk short distances independently between 12 and 15 months. Evidence: PCS. Frequency: 9/9. (PMID:32109419)
- Global developmental delay (HP:0001263): A delay in the achievement of motor or mental milestones in the domains of development of a child, including motor skills, speech and language, cognitive skills, and social and emotional skills. This term should only be used to describe children younger than five years of age. Evidence: PCS. (PMID:32109419)
- Tapered finger (HP:0001182): The gradual reduction in girth of the finger from proximal to distal. Evidence: PCS. Frequency: 2/8. (PMID:32109419)
- Prominent nasal bridge (HP:0000426): Anterior positioning of the nasal root in comparison to the usual positioning for age. Evidence: PCS. Frequency: 1/7. (PMID:32109419)
- Frontal bossing (HP:0002007): Bilateral bulging of the lateral frontal bone prominences with relative sparing of the midline. Evidence: PCS. Frequency: 5/7. (PMID:32109419)
- Attention deficit hyperactivity disorder (HP:0007018): Attention deficit hyperactivity disorder (ADHD) manifests at age 2-3 years or by first grade at the latest. The main symptoms are distractibility, impulsivity, hyperactivity, and often trouble organizing tasks and projects, difficulty going to sleep, and social problems from being aggressive, loud, or impatient. Evidence: PCS. Frequency: 4/9. (PMID:32109419)
- Autosomal dominant inheritance (HP:0000006): A mode of inheritance that is observed for traits related to a gene encoded on one of the autosomes (i.e., the human chromosomes 1-22) in which a trait manifests in heterozygotes. In the context of medical genetics, an autosomal dominant disorder is caused when a single copy of the mutant allele is present. Males and females are affected equally, and can both transmit the disorder with a risk of 50% for each child of inheriting the mutant allele. Evidence: PCS. (PMID:32109419)
These phenotypes are associated with the disease intellectual developmental disorder, autosomal dominant 63, with macrocephaly (OMIM:618825).